- Diabetes mellitus (HP:0000819): A group of abnormalities characterized by hyperglycemia and glucose intolerance. Evidence: IEA. (OMIM:129840)
- Vomiting (HP:0002013): Forceful ejection of the contents of the stomach through the mouth by means of a series of involuntary spasmic contractions. Evidence: IEA. (OMIM:129840)
- Edema (HP:0000969): An abnormal accumulation of fluid beneath the skin, or in one or more cavities of the body. Evidence: IEA. (OMIM:129840)
- Irritability (HP:0000737): An emotional state characterized by negative feelings of heightened frustration, annoyance, or feeling upset, often triggered by internal factors (e.g., fatigue, hunger, unfulfilled desires) or external factors (e.g., social or environmental challenges). Irritability may be unpredictable, and is accompanied by a lowered threshold for emotional reactivity and observable features (speech, facial expressions, or psychomotor activity). Evidence: IEA. (OMIM:129840)
- Abnormality of the genitourinary system (HP:0000119): The presence of any abnormality of the genitourinary system. Evidence: IEA. (OMIM:129840)
- Autosomal dominant inheritance (HP:0000006): A mode of inheritance that is observed for traits related to a gene encoded on one of the autosomes (i.e., the human chromosomes 1-22) in which a trait manifests in heterozygotes. In the context of medical genetics, an autosomal dominant disorder is caused when a single copy of the mutant allele is present. Males and females are affected equally, and can both transmit the disorder with a risk of 50% for each child of inheriting the mutant allele. Evidence: IEA. (OMIM:129840)
These phenotypes are associated with the disease edema, familial idiopathic, prepubertal (OMIM:129840).